Phenotypes associated with the disease Urachal cyst (ORPHA:488):
- Hematuria (HP:0000790): The presence of blood in the urine. Hematuria may be gross hematuria (visible to the naked eye) or microscopic hematuria (detected by dipstick or microscopic examination of the urine). Evidence: TAS. Frequency: Occasional (HP:0040283). (ORPHA:488)
- Fever (HP:0001945): Body temperature elevated above the normal range. Evidence: TAS. Frequency: Occasional (HP:0040283). (ORPHA:488)
- Increased total leukocyte count (HP:0001974): An abnormal increase in the number of leukocytes in the blood. Evidence: TAS. Frequency: Occasional (HP:0040283). (ORPHA:488)
- Abdominal pain (HP:0002027): An unpleasant sensation characterized by physical discomfort (such as pricking, throbbing, or aching) and perceived to originate in the abdomen. Evidence: TAS. Frequency: Occasional (HP:0040283). (ORPHA:488)
- Elevated circulating C-reactive protein concentration (HP:0011227): The concentration of C-reactive protein in the blood circulation is above the upper limit of normal. Evidence: TAS. Frequency: Occasional (HP:0040283). (ORPHA:488)
- Pyuria (HP:0012085): The presence of 10 or more white cells per cubic millimeter in a urine specimen, 3 or more white cells per high-power field of unspun urine, a positive result on Gram staining of an unspun urine specimen, or a urinary dipstick test that is positive for leukocyte esterase. Evidence: TAS. Frequency: Occasional (HP:0040283). (ORPHA:488)
- Chills (HP:0025143): A sudden sensation of feeling cold. Evidence: TAS. Frequency: Occasional (HP:0040283). (ORPHA:488)
- Abscess (HP:0025615): An abscess is a localized collection of purulent material surrounded by inflammation and granulation. Evidence: TAS. Frequency: Occasional (HP:0040283). (ORPHA:488)
- Severe infection (HP:0032169): A type of infection that is regarded as a sign of a pathological susceptibility to infection because of unusual severity or intensity of the infection. Evidence: TAS. Frequency: Occasional (HP:0040283). (ORPHA:488)
- Dysuria (HP:0100518): Painful or difficult urination. Evidence: TAS. Frequency: Occasional (HP:0040283). (ORPHA:488)
- Urachus fistula (HP:0100525): Persistence of the urachal canal with drainage of urine from the bladder through the persistent allantois canal to the umbilicus. Evidence: TAS. Frequency: Occasional (HP:0040283). (ORPHA:488)
- Peritonitis (HP:0002586): Inflammation of the peritoneum. Evidence: TAS. Frequency: Very rare (HP:0040284). (ORPHA:488)
- Neoplasm (HP:0002664): An organ or organ-system abnormality that consists of uncontrolled autonomous cell-proliferation which can occur in any part of the body as a benign or malignant neoplasm (tumor). Evidence: TAS. Frequency: Very rare (HP:0040284). (ORPHA:488)
- Ectopic calcification (HP:0010766): Deposition of calcium salts in a tissue or location in which calcification does not normally occur. Evidence: TAS. Frequency: Very rare (HP:0040284). (ORPHA:488)
- Erythema (HP:0010783): Redness of the skin, caused by hyperemia of the capillaries in the lower layers of the skin. Evidence: TAS. Frequency: Very rare (HP:0040284). (ORPHA:488)
- Abdominal mass (HP:0031500): An abnormal enlargement or swelling in the abdomen. Evidence: TAS. Frequency: Very rare (HP:0040284). (ORPHA:488)